Phenotypes associated with the disease Pfeiffer-Palm-Teller syndrome (ORPHA:2871):
- Epicanthus (HP:0000286): A fold of skin starting above the medial aspect of the upper eyelid and arching downward to cover, pass in front of and lateral to the medial canthus. Evidence: TAS. Frequency: Frequent (HP:0040282). (ORPHA:2871)
- Abnormal pinna morphology (HP:0000377): An abnormality of the pinna, which is also referred to as the auricle or external ear. Evidence: TAS. Frequency: Frequent (HP:0040282). (ORPHA:2871)
- Blepharophimosis (HP:0000581): A fixed reduction in the vertical distance between the upper and lower eyelids with short palpebral fissures. Evidence: TAS. Frequency: Frequent (HP:0040282). (ORPHA:2871)
- Intellectual disability (HP:0001249): The term intellectual disability or intellectual developmental disorder is used to describe significantly sub-average intellectual and adaptive functioning based on clinical assessment and as measured by individually administered, appropriately normed, standardized and validated tests of intellectual functioning and adaptive behavior, with onset during the developmental period from infancy through adolescence. Evidence: TAS. Frequency: Frequent (HP:0040282). (ORPHA:2871)
- Joint stiffness (HP:0001387): Joint stiffness is a perceived sensation of tightness in a joint or joints when attempting to move them after a period of inactivity. Joint stiffness typically subsides over time. Evidence: TAS. Frequency: Frequent (HP:0040282). (ORPHA:2871)
- Abnormally high-pitched voice (HP:0001620): A persistent (minutes to hours) abnormal increase in the pitch (frequency) of the voice for the context or social situation or significantly different from baseline of the individual. Evidence: TAS. Frequency: Frequent (HP:0040282). (ORPHA:2871)
- Short stature (HP:0004322): A height below that which is expected according to age and gender norms. Although there is no universally accepted definition of short stature, many refer to "short stature" as height more than 2 standard deviations below the mean for age and gender (or below the 3rd percentile for age and gender dependent norms). Evidence: TAS. Frequency: Frequent (HP:0040282). (ORPHA:2871)
- Enamel hypoplasia (HP:0006297): Developmental hypoplasia of the dental enamel. Evidence: TAS. Frequency: Frequent (HP:0040282). (ORPHA:2871)
Not associated with this disease:
- Aortic valve stenosis (HP:0001650): The presence of a stenosis (narrowing) of the aortic valve. Evidence: TAS. (ORPHA:2871)